- Autistic behavior (HP:0000729): Persistent deficits in social interaction and communication and interaction as well as a markedly restricted repertoire of activity and interest as well as repetitive patterns of behavior. Evidence: TAS. Frequency: Obligate (HP:0040280). (ORPHA:370943)
- Mild intellectual disability (HP:0001256): Mild intellectual disability (ID) is defined as a type of ID characterized by mildly sub-average adaptive functioning and intellectual functioning, with an intelligence quotient (IQ) the range of 50-69. Evidence: TAS. Frequency: Frequent (HP:0040282). (ORPHA:370943)
- Knee dislocation (HP:0004976). Evidence: TAS. Frequency: Frequent (HP:0040282). (ORPHA:370943)
- Hip dysplasia (HP:0001385): The presence of developmental dysplasia of the hip. Evidence: TAS. Frequency: Occasional (HP:0040283). (ORPHA:370943)
- Hammertoe (HP:0001765): Hyperextension of the metatarsal-phalangeal joint with hyperflexion of the proximal interphalangeal (PIP) joint. Evidence: TAS. Frequency: Occasional (HP:0040283). (ORPHA:370943)
- Generalized non-motor (absence) seizure (HP:0002121): A generalized non-motor (absence) seizure is a type of a type of dialeptic seizure that is of electrographically generalized onset. It is a generalized seizure characterized by an interruption of activities, a blank stare, and usually the person will be unresponsive when spoken to. Any ictal motor phenomena are minor in comparison to these non-motor features. Evidence: TAS. Frequency: Occasional (HP:0040283). (ORPHA:370943)
- Moderate intellectual disability (HP:0002342): Moderate intellectual disability (ID) is defined as a type of ID characterized by moderately sub-average adaptive functioning and intellectual functioning, with an intelligence quotient (IQ) the range of 35-49. Evidence: TAS. Frequency: Occasional (HP:0040283). (ORPHA:370943)
- Scoliosis (HP:0002650): The presence of an abnormal lateral curvature of the spine. Evidence: TAS. Frequency: Occasional (HP:0040283). (ORPHA:370943)
- Hip dislocation (HP:0002827): Displacement of the femur from its normal location in the hip joint. Evidence: TAS. Frequency: Occasional (HP:0040283). (ORPHA:370943)
- Severe intellectual disability (HP:0010864): Severe intellectual disability (ID) is defined as a type of ID characterized by severely sub-average adaptive functioning and intellectual functioning, with an intelligence quotient (IQ) the range of 20-34. Evidence: TAS. Frequency: Occasional (HP:0040283). (ORPHA:370943)
These phenotypes are associated with the disease Autism spectrum disorder-epilepsy-arthrogryposis syndrome (ORPHA:370943).